- Short stature (HP:0004322): A height below that which is expected according to age and gender norms. Although there is no universally accepted definition of short stature, many refer to "short stature" as height more than 2 standard deviations below the mean for age and gender (or below the 3rd percentile for age and gender dependent norms). Evidence: IEA. (OMIM:300619)
- Dysarthria (HP:0001260): Dysarthric speech is a general description referring to a neurological speech disorder characterized by poor articulation. Depending on the involved neurological structures, dysarthria may be further classified as spastic, flaccid, ataxic, hyperkinetic and hypokinetic, or mixed. Evidence: IEA. (OMIM:300619)
- X-linked recessive inheritance (HP:0001419): A mode of inheritance that is observed for recessive traits related to a gene encoded on the X chromosome. In the context of medical genetics, X-linked recessive disorders manifest in males (who have one copy of the X chromosome and are thus hemizygotes), but generally not in female heterozygotes who have one mutant and one normal allele. Evidence: IEA. (OMIM:300619)
- Hypotonia (HP:0001252): Hypotonia is an abnormally low muscle tone (the amount of tension or resistance to movement in a muscle). Even when relaxed, muscles have a continuous and passive partial contraction which provides some resistance to passive stretching. Hypotonia thus manifests as diminished resistance to passive stretching. Hypotonia is not the same as muscle weakness, although the two conditions can co-exist. Evidence: IEA. (OMIM:300619)
- Ataxia (HP:0001251): Ataxia refers to impaired coordination of voluntary muscle movement. Cerebellar ataxia refers to ataxia due to dysfunction of the cerebellum. This causes a variety of elementary neurological deficits including asynergy (lack of coordination between muscles, limbs and joints), dysmetria (lack of ability to judge distances that can lead to under- or overshoot in grasping movements), and dysdiadochokinesia (inability to perform rapid movements requiring antagonizing muscle groups to be switched on and off repeatedly). Evidence: IEA. (OMIM:300619)
- Postural tremor (HP:0002174): A type of tremors that is triggered by holding a limb in a fixed position. Evidence: IEA. (OMIM:300619)
- Generalized hypotonia (HP:0001290): Generalized muscular hypotonia (abnormally low muscle tone). Evidence: TAS. (OMIM:300619)
- Muscle weakness (HP:0001324): Reduced strength of muscles. Evidence: IEA. (OMIM:300619)
- Posterior subcapsular cataract (HP:0007787): A type of cataract affecting the posterior pole of lens immediately adjacent to ('beneath') the Lens capsule. Evidence: IEA. (OMIM:300619)
- Intellectual disability (HP:0001249): The term intellectual disability or intellectual developmental disorder is used to describe significantly sub-average intellectual and adaptive functioning based on clinical assessment and as measured by individually administered, appropriately normed, standardized and validated tests of intellectual functioning and adaptive behavior, with onset during the developmental period from infancy through adolescence. Evidence: IEA. (OMIM:300619)
These phenotypes are associated with the disease cataract, ataxia, short stature, and intellectual disability (OMIM:300619).